- Splenomegaly (HP:0001744): Abnormal increased size of the spleen. Evidence: TAS. Frequency: Very frequent (HP:0040281). (ORPHA:231242)
- Anemia (HP:0001903): A reduction in erythrocytes volume or hemoglobin concentration. Evidence: TAS. Frequency: Very frequent (HP:0040281). (ORPHA:231242)
- Microcytic anemia (HP:0001935): A kind of anemia in which the volume of the red blood cells is reduced. Evidence: TAS. Frequency: Very frequent (HP:0040281). (ORPHA:231242)
- Abnormal hemoglobin (HP:0011902): Anomaly in the level or the function of hemoglobin, the oxygen-carrying protein of erythrocytes. Evidence: TAS. Frequency: Very frequent (HP:0040281). (ORPHA:231242)
These phenotypes are associated with the disease Hemoglobin C-beta-thalassemia syndrome (ORPHA:231242).